- Autosomal recessive inheritance (HP:0000007): A mode of inheritance that is observed for traits related to a gene encoded on one of the autosomes (i.e., the human chromosomes 1-22) in which a trait manifests in individuals with two pathogenic alleles, either homozygotes (two copies of the same mutant allele) or compound heterozygotes (whereby each copy of a gene has a distinct mutant allele). Evidence: IEA. (OMIM:229650)
This phenotype is associated with the disease FRUCTOSE UTILIZATION (OMIM:229650).